Phenotypes associated with the disease Oligoarticular juvenile idiopathic arthritis (ORPHA:85410):
- Abnormal circulating interleukin concentration (HP:0011117): The concentration of an interleukin (a class of cytokines) is outside the limits of normal. Evidence: TAS. Frequency: Frequent (HP:0040282). (ORPHA:85410)
- Arthritis (HP:0001369): Inflammation of a joint. Evidence: TAS. Frequency: Very frequent (HP:0040281). (ORPHA:85410)
- Antinuclear antibody positivity (HP:0003493): The presence of autoantibodies in the serum that react against nuclei or nuclear components. Evidence: TAS. Frequency: Very frequent (HP:0040281). (ORPHA:85410)
- Oligoarthritis (HP:0040313): A type of arthritis that affects up to four joints in the first six months of disease. Evidence: TAS. Frequency: Very frequent (HP:0040281). (ORPHA:85410)
- Uveitis (HP:0000554): Inflammation of one or all portions of the uveal tract. Evidence: TAS. Frequency: Frequent (HP:0040282). (ORPHA:85410)
- Joint hypermobility (HP:0001382): The capability that a joint (or a group of joints) has to move, passively and/or actively, beyond normal limits along physiological axes. Evidence: TAS. Frequency: Frequent (HP:0040282). (ORPHA:85410)
- Failure to thrive (HP:0001508): Failure to thrive (FTT) refers to a child whose physical growth is substantially below the norm. Evidence: TAS. Frequency: Frequent (HP:0040282). (ORPHA:85410)
- Autoimmunity (HP:0002960): The occurrence of an immune reaction against the organism's own cells or tissues. Evidence: TAS. Frequency: Frequent (HP:0040282). (ORPHA:85410)
- Abnormality of the ankle (HP:0003028): An anomaly of the joint that connects the foot with the leg. Evidence: TAS. Frequency: Frequent (HP:0040282). (ORPHA:85410)
- Elevated erythrocyte sedimentation rate (HP:0003565): An increased erythrocyte sedimentation rate (ESR). The ESR is a test that measures the distance that erythrocytes have fallen after one hour in a vertical column of anticoagulated blood under the influence of gravity. The ESR is a nonspecific finding. An elevation may indicate inflammation or may be caused by any condition that elevates fibrinogen. Evidence: TAS. Frequency: Frequent (HP:0040282). (ORPHA:85410)
- Knee osteoarthritis (HP:0005086). Evidence: TAS. Frequency: Frequent (HP:0040282). (ORPHA:85410)
- Increased circulating interferon-gamma concentration (HP:0030356): An elevation in the concentration of interferon gamma measured in the blood circulation. Evidence: TAS. Frequency: Frequent (HP:0040282). (ORPHA:85410)
- Visual loss (HP:0000572): Loss of visual acuity (implying that vision was better at a certain time point in life). Otherwise the term reduced visual acuity should be used (or a subclass of that). Evidence: TAS. Frequency: Occasional (HP:0040283). (ORPHA:85410)
- Band keratopathy (HP:0000585): An abnormality of the cornea characterized by the deposition of calcium in a band across the central cornea, leading to decreased vision, foreign body sensation, and ocular irritation. Evidence: TAS. Frequency: Occasional (HP:0040283). (ORPHA:85410)
- Rheumatoid arthritis (HP:0001370): Inflammatory changes in the synovial membranes and articular structures with widespread fibrinoid degeneration of the collagen fibers in mesenchymal tissues, as well as atrophy and rarefaction of bony structures. Evidence: TAS. Frequency: Occasional (HP:0040283). (ORPHA:85410)
- Reduced visual acuity (HP:0007663). Evidence: TAS. Frequency: Occasional (HP:0040283). (ORPHA:85410)
- Anterior chamber synechiae (HP:0007833). Evidence: TAS. Frequency: Occasional (HP:0040283). (ORPHA:85410)
- Severe postnatal growth retardation (HP:0008850): Severely slow or limited growth after birth, being four standard deviations or more below age- and sex-related norms. Evidence: TAS. Frequency: Occasional (HP:0040283). (ORPHA:85410)
- Glaucoma (HP:0000501): Glaucoma refers loss of retinal ganglion cells in a characteristic pattern of optic neuropathy usually associated with increased intraocular pressure. Evidence: TAS. Frequency: Very rare (HP:0040284). (ORPHA:85410)
- Cataract (HP:0000518): A cataract is an opacity or clouding that develops in the crystalline lens of the eye or in its capsule. Evidence: TAS. Frequency: Very rare (HP:0040284). (ORPHA:85410)